Phenotypes associated with the disease Fowler urethral sphincter dysfunction syndrome (ORPHA:2795):
- Polycystic ovaries (HP:0000147). Evidence: TAS. Frequency: Frequent (HP:0040282). (ORPHA:2795)
- Abnormality of the urethra (HP:0000795): An abnormality of the urethra, i.e., of the tube which connects the urinary bladder to the outside of the body. Evidence: TAS. Frequency: Frequent (HP:0040282). (ORPHA:2795)
- EMG abnormality (HP:0003457): Abnormal results of investigations using electromyography (EMG). Evidence: TAS. Frequency: Frequent (HP:0040282). (ORPHA:2795)
- Dysuria (HP:0100518): Painful or difficult urination. Evidence: TAS. Frequency: Frequent (HP:0040282). (ORPHA:2795)
- Urinary retention (HP:0000016): Inability to completely empty the urinary bladder during the process of urination. Evidence: TAS. Frequency: Occasional (HP:0040283). (ORPHA:2795)
- Oligomenorrhea (HP:0000876): Infrequent menses (less than 6 per year or more than 35 days between cycles). Evidence: TAS. Frequency: Occasional (HP:0040283). (ORPHA:2795)
- Hirsutism (HP:0001007): Abnormally increased hair growth referring to a male pattern of body hair (androgenic hair). Evidence: TAS. Frequency: Occasional (HP:0040283). (ORPHA:2795)
- Acne (HP:0001061): A skin condition in which there is an increase in sebum secretion by the pilosebaceous apparatus associated with open comedones (blackheads), closed comedones (whiteheads), and pustular nodules (papules, pustules, and cysts). Evidence: TAS. Frequency: Occasional (HP:0040283). (ORPHA:2795)
- Urinary incontinence (HP:0000020): Loss of the ability to control the urinary bladder leading to involuntary urination. Evidence: TAS. Frequency: Very rare (HP:0040284). (ORPHA:2795)
- Menorrhagia (HP:0000132): Prolonged and excessive menses at regular intervals in excess of 80 mL or lasting longer than 7 days. Evidence: TAS. Frequency: Very rare (HP:0040284). (ORPHA:2795)
- Abnormality of the ovary (HP:0000137): An abnormality of the ovary. Evidence: TAS. Frequency: Very rare (HP:0040284). (ORPHA:2795)
- Amenorrhea (HP:0000141): Absence of menses for an interval of time equivalent to a total of more than (or equal to) 3 previous cycles or 6 months. Evidence: TAS. Frequency: Very rare (HP:0040284). (ORPHA:2795)